- Premature ovarian insufficiency (HP:0008209): Amenorrhea due to loss of ovarian function before the age of 40. Primary ovarian insuficiency (POI) is a state of female hypergonadotropic hypogonadism. It can manifest as primary amenorrhea with onset before menarche or secondary amenorrhea. Evidence: PCS. Frequency: 2/2. (PMID:12707859)
- Memory impairment (HP:0002354): An impairment of memory as manifested by a reduced ability to remember things such as dates and names, and increased forgetfulness. Evidence: PCS. Frequency: 1/1. (PMID:21484434)
- Cataract (HP:0000518): A cataract is an opacity or clouding that develops in the crystalline lens of the eye or in its capsule. Evidence: PCS. Frequency: 1/1. (PMID:21484434)
- Dysarthria (HP:0001260): Dysarthric speech is a general description referring to a neurological speech disorder characterized by poor articulation. Depending on the involved neurological structures, dysarthria may be further classified as spastic, flaccid, ataxic, hyperkinetic and hypokinetic, or mixed. Evidence: PCS. Frequency: 1/2. (PMID:12707859)
- Secondary amenorrhea (HP:0000869). Evidence: PCS. Frequency: 1/1. (PMID:21484434)
- Lower limb muscle weakness (HP:0007340): Weakness of the muscles of the legs. Evidence: PCS. Frequency: 1/1. (PMID:21484434)
- Leukoencephalopathy (HP:0002352): This term describes abnormality of the white matter of the cerebrum resulting from damage to the myelin sheaths of nerve cells. Evidence: PCS. Frequency: 1/1. (PMID:21484434)
- Autosomal recessive inheritance (HP:0000007): A mode of inheritance that is observed for traits related to a gene encoded on one of the autosomes (i.e., the human chromosomes 1-22) in which a trait manifests in individuals with two pathogenic alleles, either homozygotes (two copies of the same mutant allele) or compound heterozygotes (whereby each copy of a gene has a distinct mutant allele). Evidence: PCS. (PMID:11704758)
- Unsteady gait (HP:0002317). Evidence: PCS. Frequency: 1/2. Onset: Juvenile onset (HP:0003621). (PMID:12707859)
- Unsteady gait (HP:0002317). Evidence: PCS. Frequency: 1/1. (PMID:21484434)
- Optic atrophy (HP:0000648): Atrophy of the optic nerve. Optic atrophy results from the death of the retinal ganglion cell axons that comprise the optic nerve and manifesting as a pale optic nerve on fundoscopy. Evidence: PCS. Frequency: 0/2. (PMID:12707859)
- Spasticity (HP:0001257): A motor disorder characterized by a velocity-dependent increase in tonic stretch reflexes with increased muscle tone, exaggerated (hyperexcitable) tendon reflexes. Evidence: PCS. Frequency: 2/2. (PMID:12707859)
These phenotypes are associated with the disease leukoencephalopathy with vanishing white matter 2 (OMIM:620312).